- Congenital onset (HP:0003577): A phenotypic abnormality that is present at birth. Evidence: PCS. Frequency: 2/4. (PMID:29255262)
- Early young adult onset (HP:0025708): Onset of disease at an age of greater than or equal to 16 to under 19 years. Evidence: PCS. Frequency: 1/4. (PMID:29255262)
- Halitosis (HP:0100812): Noticeably unpleasant odors exhaled in breathing. Evidence: PCS. Frequency: 4/4. (PMID:29255262)
- Infantile onset (HP:0003593): Onset of signs or symptoms of disease between 28 days to one year of life. Evidence: PCS. Frequency: 1/4. (PMID:29255262)
- Autosomal recessive inheritance (HP:0000007): A mode of inheritance that is observed for traits related to a gene encoded on one of the autosomes (i.e., the human chromosomes 1-22) in which a trait manifests in individuals with two pathogenic alleles, either homozygotes (two copies of the same mutant allele) or compound heterozygotes (whereby each copy of a gene has a distinct mutant allele). Evidence: PCS. (PMID:29255262)
These phenotypes are associated with the disease extraoral halitosis due to methanethiol oxidase deficiency (OMIM:618148).